Phenotypes associated with the disease hearing loss, autosomal recessive 113 (OMIM:618410):
- Juvenile onset (HP:0003621): Onset of signs or symptoms of disease between the age of 5 and 15 years. Evidence: PCS. Frequency: 7/7. (PMID:29703829)
- Abnormal vestibular function (HP:0001751): An abnormality of the functioning of the vestibular apparatus. Evidence: PCS. Frequency: 0/7. (PMID:29703829)
- Sensorineural hearing impairment (HP:0000407): A type of hearing impairment in one or both ears related to an abnormal functionality of the cochlear nerve. Evidence: PCS. Frequency: 7/7. Onset: Juvenile onset (HP:0003621). (PMID:29703829)
- Autosomal recessive inheritance (HP:0000007): A mode of inheritance that is observed for traits related to a gene encoded on one of the autosomes (i.e., the human chromosomes 1-22) in which a trait manifests in individuals with two pathogenic alleles, either homozygotes (two copies of the same mutant allele) or compound heterozygotes (whereby each copy of a gene has a distinct mutant allele). Evidence: PCS. (PMID:29703829)